Phenotypes associated with the disease Intellectual disability-coarse face-macrocephaly-cerebellar hypotrophy syndrome (ORPHA:397709):
- Coarse facial features (HP:0000280): Absence of fine and sharp appearance of brows, nose, lips, mouth, and chin, usually because of rounded and heavy features or thickened skin with or without thickening of subcutaneous and bony tissues. Evidence: TAS. Frequency: Very frequent (HP:0040281). (ORPHA:397709)
- Delayed speech and language development (HP:0000750): A degree of language development that is significantly below the norm for a child of a specified age. Evidence: TAS. Frequency: Very frequent (HP:0040281). (ORPHA:397709)
- Delayed gross motor development (HP:0002194): A type of motor delay characterized by a delay in acquiring the ability to control the large muscles of the body for walking, running, sitting, and crawling. Evidence: TAS. Frequency: Very frequent (HP:0040281). (ORPHA:397709)
- Aplasia/Hypoplasia of the cerebellum (HP:0007360). Evidence: TAS. Frequency: Very frequent (HP:0040281). (ORPHA:397709)
- Delayed fine motor development (HP:0010862): A type of motor delay characterized by a delay in acquiring the ability to control the fingers and hands. Evidence: TAS. Frequency: Very frequent (HP:0040281). (ORPHA:397709)
- Severe intellectual disability (HP:0010864): Severe intellectual disability (ID) is defined as a type of ID characterized by severely sub-average adaptive functioning and intellectual functioning, with an intelligence quotient (IQ) the range of 20-34. Evidence: TAS. Frequency: Very frequent (HP:0040281). (ORPHA:397709)
- Severe global developmental delay (HP:0011344): A severe delay in the achievement of motor or mental milestones in the domains of development of a child. Evidence: TAS. Frequency: Very frequent (HP:0040281). (ORPHA:397709)
- Macroglossia (HP:0000158): Increased length and width of the tongue. Evidence: TAS. Frequency: Frequent (HP:0040282). (ORPHA:397709)
- Sensorineural hearing impairment (HP:0000407): A type of hearing impairment in one or both ears related to an abnormal functionality of the cochlear nerve. Evidence: TAS. Frequency: Frequent (HP:0040282). (ORPHA:397709)
- Nystagmus (HP:0000639): Rhythmic, involuntary oscillations of one or both eyes related to abnormality in fixation, conjugate gaze, or vestibular mechanisms. Evidence: TAS. Frequency: Frequent (HP:0040282). (ORPHA:397709)
- Autistic behavior (HP:0000729): Persistent deficits in social interaction and communication and interaction as well as a markedly restricted repertoire of activity and interest as well as repetitive patterns of behavior. Evidence: TAS. Frequency: Frequent (HP:0040282). (ORPHA:397709)
- Ataxia (HP:0001251): Ataxia refers to impaired coordination of voluntary muscle movement. Cerebellar ataxia refers to ataxia due to dysfunction of the cerebellum. This causes a variety of elementary neurological deficits including asynergy (lack of coordination between muscles, limbs and joints), dysmetria (lack of ability to judge distances that can lead to under- or overshoot in grasping movements), and dysdiadochokinesia (inability to perform rapid movements requiring antagonizing muscle groups to be switched on and off repeatedly). Evidence: TAS. Frequency: Frequent (HP:0040282). (ORPHA:397709)
- Hypotonia (HP:0001252): Hypotonia is an abnormally low muscle tone (the amount of tension or resistance to movement in a muscle). Even when relaxed, muscles have a continuous and passive partial contraction which provides some resistance to passive stretching. Hypotonia thus manifests as diminished resistance to passive stretching. Hypotonia is not the same as muscle weakness, although the two conditions can co-exist. Evidence: TAS. Frequency: Frequent (HP:0040282). (ORPHA:397709)
- Absent speech (HP:0001344): Complete lack of development of speech and language abilities. Evidence: TAS. Frequency: Frequent (HP:0040282). (ORPHA:397709)
- Frontal bossing (HP:0002007): Bilateral bulging of the lateral frontal bone prominences with relative sparing of the midline. Evidence: TAS. Frequency: Frequent (HP:0040282). (ORPHA:397709)
- Broad-based gait (HP:0002136): An abnormal gait pattern in which persons stand and walk with their feet spaced widely apart. This is often a component of cerebellar ataxia. Evidence: TAS. Frequency: Frequent (HP:0040282). (ORPHA:397709)
- Kyphoscoliosis (HP:0002751): An abnormal curvature of the spine in both a coronal (lateral) and sagittal (back-to-front) plane. Evidence: TAS. Frequency: Frequent (HP:0040282). (ORPHA:397709)
- Relative macrocephaly (HP:0004482): A relatively mild degree of macrocephaly in which the head circumference is not above two standard deviations from the mean, but appears dysproportionately large when other factors such as body stature are taken into account. Evidence: TAS. Frequency: Frequent (HP:0040282). (ORPHA:397709)
- Abnormal skeletal morphology (HP:0011842): An abnormality of the form, structure, or size of the skeletal system. Evidence: TAS. Frequency: Frequent (HP:0040282). (ORPHA:397709)
- Palpebral edema (HP:0100540): Edema in the region of the eyelids. Evidence: TAS. Frequency: Frequent (HP:0040282). (ORPHA:397709)
- High palate (HP:0000218): Height of the palate more than 2 SD above the mean (objective) or palatal height at the level of the first permanent molar more than twice the height of the teeth (subjective). Evidence: TAS. Frequency: Occasional (HP:0040283). (ORPHA:397709)
- Broad philtrum (HP:0000289): Distance between the philtral ridges, measured just above the vermilion border, more than 2 standard deviations above the mean, or alternatively, an apparently increased distance between the ridges of the philtrum. Evidence: TAS. Frequency: Occasional (HP:0040283). (ORPHA:397709)
- Full cheeks (HP:0000293): Increased prominence or roundness of soft tissues between zygomata and mandible. Evidence: TAS. Frequency: Occasional (HP:0040283). (ORPHA:397709)
- Pointed chin (HP:0000307): A marked tapering of the lower face to the chin. Evidence: TAS. Frequency: Occasional (HP:0040283). (ORPHA:397709)
- Long philtrum (HP:0000343): Distance between nasal base and midline upper lip vermilion border more than 2 SD above the mean. Alternatively, an apparently increased distance between nasal base and midline upper lip vermilion border. Evidence: TAS. Frequency: Occasional (HP:0040283). (ORPHA:397709)
- Small forehead (HP:0000350): The presence of a forehead that is abnormally small. Evidence: TAS. Frequency: Occasional (HP:0040283). (ORPHA:397709)
- Wide nasal bridge (HP:0000431): Increased breadth of the nasal bridge (and with it, the nasal root). Evidence: TAS. Frequency: Occasional (HP:0040283). (ORPHA:397709)
- Telecanthus (HP:0000506): Distance between the inner canthi more than two standard deviations above the mean (objective); or, apparently increased distance between the inner canthi. Evidence: TAS. Frequency: Occasional (HP:0040283). (ORPHA:397709)
- Dental crowding (HP:0000678): Changes in alignment of teeth in the dental arch. Evidence: TAS. Frequency: Occasional (HP:0040283). (ORPHA:397709)
- Pectus carinatum (HP:0000768): A deformity of the chest caused by overgrowth of the ribs and characterized by protrusion of the sternum. Evidence: TAS. Frequency: Occasional (HP:0040283). (ORPHA:397709)
- Brachydactyly (HP:0001156): Digits that appear disproportionately short compared to the hand/foot. The word brachydactyly is used here to describe a series distinct patterns of shortened digits (brachydactyly types A-E). This is the sense used here. Evidence: TAS. Frequency: Occasional (HP:0040283). (ORPHA:397709)
- Seizure (HP:0001250): A seizure is an intermittent abnormality of nervous system physiology characterized by a transient occurrence of signs and/or symptoms due to abnormal excessive or synchronous neuronal activity in the brain. Evidence: TAS. Frequency: Occasional (HP:0040283). (ORPHA:397709)
- Spasticity (HP:0001257): A motor disorder characterized by a velocity-dependent increase in tonic stretch reflexes with increased muscle tone, exaggerated (hyperexcitable) tendon reflexes. Evidence: TAS. Frequency: Occasional (HP:0040283). (ORPHA:397709)
- Hyporeflexia (HP:0001265): Reduction of neurologic reflexes such as the knee-jerk reaction. Evidence: TAS. Frequency: Occasional (HP:0040283). (ORPHA:397709)
- Hepatosplenomegaly (HP:0001433): Simultaneous enlargement of the liver and spleen. Evidence: TAS. Frequency: Occasional (HP:0040283). (ORPHA:397709)
- Atrial septal defect (HP:0001631): Atrial septal defect (ASD) is a congenital abnormality of the interatrial septum that enables blood flow between the left and right atria via the interatrial septum. Evidence: TAS. Frequency: Occasional (HP:0040283). (ORPHA:397709)
- Patent ductus arteriosus (HP:0001643): In utero, the ductus arteriosus (DA) serves to divert ventricular output away from the lungs and toward the placenta by connecting the main pulmonary artery to the descending aorta. A patent ductus arteriosus (PDA) in the first 3 days of life is a physiologic shunt in healthy term and preterm newborn infants, and normally is substantially closed within about 24 hours after bith and completely closed after about three weeks. Failure of physiologcal closure is referred to a persistent or patent ductus arteriosus (PDA). Depending on the degree of left-to-right shunting, PDA can have clinical consequences. Evidence: TAS. Frequency: Occasional (HP:0040283). (ORPHA:397709)
- Talipes equinovarus (HP:0001762): Talipes equinovarus (also called clubfoot) typically has four main components: inversion and adduction of the forefoot; inversion of the heel and hindfoot; equinus (limitation of extension) of the ankle and subtalar joint; and internal rotation of the leg. Evidence: TAS. Frequency: Occasional (HP:0040283). (ORPHA:397709)
- Deep philtrum (HP:0002002): Accentuated, prominent philtral ridges giving rise to an exaggerated groove in the midline between the nasal base and upper vermillion border. Evidence: TAS. Frequency: Occasional (HP:0040283). (ORPHA:397709)
- Apraxia (HP:0002186): A defect in the understanding of complex motor commands and in the execution of certain learned movements, i.e., deficits in the cognitive components of learned movements. Evidence: TAS. Frequency: Occasional (HP:0040283). (ORPHA:397709)
- Facial hypertrichosis (HP:0002219): Excessive, increased hair growth located in the facial region. Evidence: TAS. Frequency: Occasional (HP:0040283). (ORPHA:397709)
- Abnormal cerebral white matter morphology (HP:0002500): An abnormality of the cerebral white matter. Evidence: TAS. Frequency: Occasional (HP:0040283). (ORPHA:397709)
- Thickened calvaria (HP:0002684): The presence of an abnormally thick calvaria. Evidence: TAS. Frequency: Occasional (HP:0040283). (ORPHA:397709)
- Babinski sign (HP:0003487): Upturning of the big toe (and sometimes fanning of the other toes) in response to stimulation of the sole of the foot. If the Babinski sign is present it can indicate damage to the corticospinal tract. Evidence: TAS. Frequency: Occasional (HP:0040283). (ORPHA:397709)
- Depressed nasal bridge (HP:0005280): Posterior positioning of the nasal root in relation to the overall facial profile for age. Evidence: TAS. Frequency: Occasional (HP:0040283). (ORPHA:397709)
- Retrocerebellar cyst (HP:0006951). Evidence: TAS. Frequency: Occasional (HP:0040283). (ORPHA:397709)
- Neuropathic spinal arthropathy (HP:0008443): A progressive disorder of vertebral joint degeneration that occurs in the setting of any condition characterized by decreased afferent innervation, involving loss of deep pain and proprioceptive sensation in the vertebral column. Patients most commonly present with symptoms of lower back pain, sitting imbalance, progressive spinal deformity (usually kyphosis), and an audible clicking sound on changing postures. Evidence: TAS. Frequency: Occasional (HP:0040283). (ORPHA:397709)
- Oligosacchariduria (HP:0010471): Increased urinary excretion of oligosaccharides (low molecular weight carbohydrate chains composed of at least three monosaccharide subunits), derived from a partial degradation of glycoproteins. Evidence: TAS. Frequency: Occasional (HP:0040283). (ORPHA:397709)
- Hypoplasia of the pons (HP:0012110): Underdevelopment of the pons. Evidence: TAS. Frequency: Occasional (HP:0040283). (ORPHA:397709)
- Camptodactyly (HP:0012385): The distal interphalangeal joint and/or the proximal interphalangeal joint of the fingers or toes cannot be extended to 180 degrees by either active or passive extension. Evidence: TAS. Frequency: Occasional (HP:0040283). (ORPHA:397709)
- Thick vermilion border (HP:0012471): Increased width of the skin of vermilion border region of upper lip. Evidence: TAS. Frequency: Occasional (HP:0040283). (ORPHA:397709)
- Short palpebral fissure (HP:0012745): Distance between the medial and lateral canthi is more than 2 SD below the mean for age (objective); or, apparently reduced length of the palpebral fissures. Evidence: TAS. Frequency: Occasional (HP:0040283). (ORPHA:397709)
- Wide nasal base (HP:0012810): Increased distance between the attachments of the alae nasi to the face. Evidence: TAS. Frequency: Occasional (HP:0040283). (ORPHA:397709)
- Clinodactyly (HP:0030084): An angulation of a digit at an interphalangeal joint in the plane of the palm (finger) or sole (toe). Evidence: TAS. Frequency: Occasional (HP:0040283). (ORPHA:397709)